Phenotypes associated with the disease premature ovarian failure 25 (OMIM:621002):
- Autoimmunity (HP:0002960): The occurrence of an immune reaction against the organism's own cells or tissues. Evidence: PCS. Frequency: 0/2. (PMID:35285020)
- Premature ovarian insufficiency (HP:0008209): Amenorrhea due to loss of ovarian function before the age of 40. Primary ovarian insuficiency (POI) is a state of female hypergonadotropic hypogonadism. It can manifest as primary amenorrhea with onset before menarche or secondary amenorrhea. Evidence: PCS. Frequency: 2/2. (PMID:35285020)
- Irregular menstruation (HP:0000858): Abnormally high variation in the amount of time between periods. Evidence: PCS. Frequency: 2/2. (PMID:35285020)
- Female infertility (HP:0008222). Evidence: PCS. Frequency: 2/2. (PMID:35285020)
- Young adult onset (HP:0011462): Onset of disease at the age of between 16 and 40 years. Evidence: PCS. Frequency: 2/2. (PMID:35285020)
- Elevated circulating follicle stimulating hormone level (HP:0008232): An elevated concentration of follicle-stimulating hormone in the blood. Evidence: PCS. Frequency: 2/2. (PMID:35285020)
- Autosomal recessive inheritance (HP:0000007): A mode of inheritance that is observed for traits related to a gene encoded on one of the autosomes (i.e., the human chromosomes 1-22) in which a trait manifests in individuals with two pathogenic alleles, either homozygotes (two copies of the same mutant allele) or compound heterozygotes (whereby each copy of a gene has a distinct mutant allele). Evidence: PCS. (PMID:35285020)
- Decreased circulating antimullerian hormone circulation (HP:0031103): A reduction below the normal range of the antimullerian hormone in the circulation. Evidence: PCS. Frequency: 2/2. (PMID:35285020)